- Abnormal palate morphology (HP:0000174): Any abnormality of the palate, i.e., of roof of the mouth. Evidence: TAS. Frequency: Very frequent (HP:0040281). (ORPHA:1506)
- Macrocephaly (HP:0000256): Occipitofrontal (head) circumference greater than 97th centile compared to appropriate, age matched, sex-matched normal standards. Alternatively, a apparently increased size of the cranium. Evidence: TAS. Frequency: Very frequent (HP:0040281). (ORPHA:1506)
- Abnormal rib morphology (HP:0000772): An anomaly of the rib. Evidence: TAS. Frequency: Very frequent (HP:0040281). (ORPHA:1506)
- Intrauterine growth retardation (HP:0001511): An abnormal restriction of fetal growth with fetal weight below the tenth percentile for gestational age. Evidence: TAS. Frequency: Very frequent (HP:0040281). (ORPHA:1506)
- Frontal bossing (HP:0002007): Bilateral bulging of the lateral frontal bone prominences with relative sparing of the midline. Evidence: TAS. Frequency: Very frequent (HP:0040281). (ORPHA:1506)
- Abnormal pelvic girdle bone morphology (HP:0002644): An abnormality of the bony pelvic girdle, which is a ring of bones connecting the vertebral column to the femurs. Evidence: TAS. Frequency: Very frequent (HP:0040281). (ORPHA:1506)
- Slender long bone (HP:0003100): Reduced diameter of a long bone. Evidence: TAS. Frequency: Very frequent (HP:0040281). (ORPHA:1506)
- Posteriorly rotated ears (HP:0000358): A type of abnormal location of the ears in which the position of the ears is characterized by posterior rotation (the superior part of the ears is rotated towards the back of the head, and the inferior part of the ears towards the front). Evidence: TAS. Frequency: Very frequent (HP:0040281). (ORPHA:1506)
These phenotypes are associated with the disease Thin ribs-tubular bones-dysmorphism syndrome (ORPHA:1506).